- Facial asymmetry (HP:0000324): An abnormal difference between the left and right sides of the face. Evidence: TAS. Frequency: Occasional (HP:0040283). (ORPHA:52429)
- Micrognathia (HP:0000347): Developmental hypoplasia of the mandible. Evidence: TAS. Frequency: Occasional (HP:0040283). (ORPHA:52429)
- Abnormality of the outer ear (HP:0000356): An abnormality of the external ear. Evidence: TAS. Frequency: Frequent (HP:0040282). (ORPHA:52429)
- Abnormality of the inner ear (HP:0000359): An abnormality of the inner ear. Evidence: TAS. Frequency: Frequent (HP:0040282). (ORPHA:52429)
- Preauricular skin tag (HP:0000384): A rudimentary tag of skin often containing ear tissue including a core of cartilage and located just anterior to the auricle (outer part of the ear). Evidence: TAS. Frequency: Occasional (HP:0040283). (ORPHA:52429)
- Conductive hearing impairment (HP:0000405): An abnormality of vibrational conductance of sound to the inner ear leading to impairment of sensory perception of sound. Evidence: TAS. Frequency: Frequent (HP:0040282). (ORPHA:52429)
- Sensorineural hearing impairment (HP:0000407): A type of hearing impairment in one or both ears related to an abnormal functionality of the cochlear nerve. Evidence: TAS. Frequency: Frequent (HP:0040282). (ORPHA:52429)
- Atresia of the external auditory canal (HP:0000413): Absence or failure to form of the external auditory canal. Evidence: TAS. Frequency: Frequent (HP:0040282). (ORPHA:52429)
- Preauricular pit (HP:0004467): Small indentation anterior to the insertion of the ear. Evidence: TAS. Frequency: Very frequent (HP:0040281). (ORPHA:52429)
- Abnormal middle ear morphology (HP:0008609): An abnormality of the morphology or structure of the middle ear. Evidence: TAS. Frequency: Frequent (HP:0040282). (ORPHA:52429)
- Branchial fistula (HP:0009795): A congenital fistula in the neck resulting from incomplete closure of a branchial cleft. Evidence: TAS. Frequency: Frequent (HP:0040282). (ORPHA:52429)
- Facial palsy (HP:0010628): Facial nerve palsy is a dysfunction of cranial nerve VII (the facial nerve) that results in inability to control facial muscles on the affected side with weakness of the muscles of facial expression and eye closure. This can either be present in unilateral or bilateral form. Evidence: TAS. Frequency: Occasional (HP:0040283). (ORPHA:52429)
- Cleft palate (HP:0000175): Cleft palate is a developmental defect of the palate resulting from a failure of fusion of the palatine processes and manifesting as a separation of the roof of the mouth (soft and hard palate). Evidence: TAS. Frequency: Occasional (HP:0040283). (ORPHA:52429)
- Hearing impairment (HP:0000365): A decreased magnitude of the sensory perception of sound. Evidence: TAS. Frequency: Very frequent (HP:0040281). (ORPHA:52429)
- Abnormal nasolacrimal system morphology (HP:0000614): An abnormality of the nasolacrimal drainage system, which serves as a conduit for tear flow from the external eye to the nasal cavity. Evidence: TAS. Frequency: Occasional (HP:0040283). (ORPHA:52429)
- Lip pit (HP:0100267): A depression located on a lip. Evidence: TAS. Frequency: Occasional (HP:0040283). (ORPHA:52429)
These phenotypes are associated with the disease Branchiootic syndrome (ORPHA:52429).